Phenotypes associated with the disease Vitamin B12-responsive methylmalonic acidemia (ORPHA:28):
- Renal insufficiency (HP:0000083): A reduction in the level of performance of the kidneys in areas of function comprising the concentration of urine, removal of wastes, the maintenance of electrolyte balance, homeostasis of blood pressure, and calcium metabolism. Evidence: TAS. Frequency: Occasional (HP:0040283). (ORPHA:28)
- Intellectual disability (HP:0001249): The term intellectual disability or intellectual developmental disorder is used to describe significantly sub-average intellectual and adaptive functioning based on clinical assessment and as measured by individually administered, appropriately normed, standardized and validated tests of intellectual functioning and adaptive behavior, with onset during the developmental period from infancy through adolescence. Evidence: TAS. Frequency: Frequent (HP:0040282). (ORPHA:28)
- Hypotonia (HP:0001252): Hypotonia is an abnormally low muscle tone (the amount of tension or resistance to movement in a muscle). Even when relaxed, muscles have a continuous and passive partial contraction which provides some resistance to passive stretching. Hypotonia thus manifests as diminished resistance to passive stretching. Hypotonia is not the same as muscle weakness, although the two conditions can co-exist. Evidence: TAS. Frequency: Frequent (HP:0040282). (ORPHA:28)
- Lethargy (HP:0001254): A state of fatigue, either physical or mental slowness and sluggishness, with difficulties in initiating or performing simple tasks. Distinguished from apathy which implies indifference and a lack of desire or interest in the task. A person with lethargy may have the desire, but not the energy to engage in personal or socially relevant tasks. Evidence: TAS. Frequency: Very frequent (HP:0040281). (ORPHA:28)
- Coma (HP:0001259): The complete absence of wakefulness and consciousness, which is evident through a lack of response to any form of external stimuli. Evidence: TAS. Frequency: Very frequent (HP:0040281). (ORPHA:28)
- Global developmental delay (HP:0001263): A delay in the achievement of motor or mental milestones in the domains of development of a child, including motor skills, speech and language, cognitive skills, and social and emotional skills. This term should only be used to describe children younger than five years of age. Evidence: TAS. Frequency: Frequent (HP:0040282). (ORPHA:28)
- Failure to thrive (HP:0001508): Failure to thrive (FTT) refers to a child whose physical growth is substantially below the norm. Evidence: TAS. Frequency: Very frequent (HP:0040281). (ORPHA:28)
- Anemia (HP:0001903): A reduction in erythrocytes volume or hemoglobin concentration. Evidence: TAS. Frequency: Occasional (HP:0040283). (ORPHA:28)
- Dehydration (HP:0001944). Evidence: TAS. Frequency: Very frequent (HP:0040281). (ORPHA:28)
- Hyperammonemia (HP:0001987): An increased concentration of ammonia in the blood. Evidence: TAS. Frequency: Frequent (HP:0040282). (ORPHA:28)
- Nausea and vomiting (HP:0002017): Nausea is a commonly encountered symptom that has been defined as an unpleasant painless subjective feeling that one will imminently vomit. Vomiting has been defined as the forceful expulsion of the contents of the stomach, duodenum, or jejunum through the oral cavity. While nausea and vomiting are often thought to exist on a temporal continuum, this is not always the case. There are situations when severe nausea may be present without emesis and less frequently, when emesis may be present without preceding nausea. Evidence: TAS. Frequency: Very frequent (HP:0040281). (ORPHA:28)
- Respiratory insufficiency (HP:0002093). Evidence: TAS. Frequency: Very frequent (HP:0040281). (ORPHA:28)
- Hepatomegaly (HP:0002240): Abnormally increased size of the liver. Evidence: TAS. Frequency: Very frequent (HP:0040281). (ORPHA:28)